Phenotypes associated with the disease RARS-related autosomal recessive hypomyelinating leukodystrophy (ORPHA:438114):
- Nystagmus (HP:0000639): Rhythmic, involuntary oscillations of one or both eyes related to abnormality in fixation, conjugate gaze, or vestibular mechanisms. Evidence: TAS. Frequency: Frequent (HP:0040282). (ORPHA:438114)
- Reduced eye contact (HP:0000817): A reduced frequency or duration of eye contact. Evidence: TAS. Frequency: Frequent (HP:0040282). (ORPHA:438114)
- Ataxia (HP:0001251): Ataxia refers to impaired coordination of voluntary muscle movement. Cerebellar ataxia refers to ataxia due to dysfunction of the cerebellum. This causes a variety of elementary neurological deficits including asynergy (lack of coordination between muscles, limbs and joints), dysmetria (lack of ability to judge distances that can lead to under- or overshoot in grasping movements), and dysdiadochokinesia (inability to perform rapid movements requiring antagonizing muscle groups to be switched on and off repeatedly). Evidence: TAS. Frequency: Frequent (HP:0040282). (ORPHA:438114)
- Mild intellectual disability (HP:0001256): Mild intellectual disability (ID) is defined as a type of ID characterized by mildly sub-average adaptive functioning and intellectual functioning, with an intelligence quotient (IQ) the range of 50-69. Evidence: TAS. Frequency: Frequent (HP:0040282). (ORPHA:438114)
- Dysarthria (HP:0001260): Dysarthric speech is a general description referring to a neurological speech disorder characterized by poor articulation. Depending on the involved neurological structures, dysarthria may be further classified as spastic, flaccid, ataxic, hyperkinetic and hypokinetic, or mixed. Evidence: TAS. Frequency: Frequent (HP:0040282). (ORPHA:438114)
- Global developmental delay (HP:0001263): A delay in the achievement of motor or mental milestones in the domains of development of a child, including motor skills, speech and language, cognitive skills, and social and emotional skills. This term should only be used to describe children younger than five years of age. Evidence: TAS. Frequency: Frequent (HP:0040282). (ORPHA:438114)
- Gait disturbance (HP:0001288): The term gait disturbance can refer to any disruption of the ability to walk. Evidence: TAS. Frequency: Frequent (HP:0040282). (ORPHA:438114)
- Dysmetria (HP:0001310): A type of ataxia characterized by the inability to carry out movements with the correct range and motion across the plane of more than one joint related to incorrect estimation of the distances required for targeted movements. Evidence: TAS. Frequency: Frequent (HP:0040282). (ORPHA:438114)
- Dystonia (HP:0001332): An abnormally increased muscular tone that causes fixed abnormal postures. There is a slow, intermittent twisting motion that leads to exaggerated turning and posture of the extremities and trunk. Evidence: TAS. Frequency: Frequent (HP:0040282). (ORPHA:438114)
- Hyperreflexia (HP:0001347): Hyperreflexia is the presence of hyperactive stretch reflexes of the muscles. Evidence: TAS. Frequency: Frequent (HP:0040282). (ORPHA:438114)
- Lower limb spasticity (HP:0002061): Spasticity (velocity-dependent increase in tonic stretch reflexes with increased muscle tone and hyperexcitable tendon reflexes) in the muscles of the lower limbs, hips, and pelvis. Evidence: TAS. Frequency: Frequent (HP:0040282). (ORPHA:438114)
- Hypoplasia of the corpus callosum (HP:0002079): Underdevelopment of the corpus callosum. Evidence: TAS. Frequency: Frequent (HP:0040282). (ORPHA:438114)
- Intention tremor (HP:0002080): A type of kinetic tremor that occurs during target directed movement is called intention tremor. That is, an oscillatory cerebellar ataxia that tends to be absent when the limbs are inactive and during the first part of voluntary movement but worsening as the movement continues and greater precision is required (e.g., in touching a target such as the patient's nose or a physician's finger). Evidence: TAS. Frequency: Frequent (HP:0040282). (ORPHA:438114)
- Poor head control (HP:0002421): Difficulty to maintain correct position of the head while standing or sitting. Infant head lag is observed when the head seems to flop around or lags posteriorly behind the trunk. Several articles have maintained that head lag should be absent by age 3 to 4 months. Evidence: TAS. Frequency: Frequent (HP:0040282). (ORPHA:438114)
- Cerebral hypomyelination (HP:0006808): Reduced amount of myelin in the nervous system resulting from defective myelinogenesis in the white matter of the central nervous system. Evidence: TAS. Frequency: Frequent (HP:0040282). (ORPHA:438114)
- Lower limb hypertonia (HP:0006895). Evidence: TAS. Frequency: Frequent (HP:0040282). (ORPHA:438114)
- Progressive extrapyramidal movement disorder (HP:0007153). Evidence: TAS. Frequency: Frequent (HP:0040282). (ORPHA:438114)
- Developmental stagnation (HP:0007281): A cessation of the development of a child in the areas of motor skills, speech and language, cognitive skills, and social and/or emotional skills. Evidence: TAS. Frequency: Frequent (HP:0040282). (ORPHA:438114)
- Axial hypotonia (HP:0008936): Muscular hypotonia (abnormally low muscle tone) affecting the musculature of the trunk. Evidence: TAS. Frequency: Frequent (HP:0040282). (ORPHA:438114)
- Hyperintensity of cerebral white matter on MRI (HP:0030890): A brighter than expected signal on magnetic resonance imaging emanating from the cerebral white matter. Evidence: TAS. Frequency: Frequent (HP:0040282). (ORPHA:438114)
- Microcephaly (HP:0000252): Head circumference below 2 standard deviations below the mean for age and gender. Evidence: TAS. Frequency: Occasional (HP:0040283). (ORPHA:438114)
- Vomiting (HP:0002013): Forceful ejection of the contents of the stomach through the mouth by means of a series of involuntary spasmic contractions. Evidence: TAS. Frequency: Occasional (HP:0040283). (ORPHA:438114)
- Increased circulating lactate concentration (HP:0002151): Abnormally increased level of blood lactate (2-hydroxypropanoic acid). Lactate is produced from pyruvate by lactate dehydrogenase during normal metabolism. The terms lactate and lactic acid are often used interchangeably but lactate (the component measured in blood) is strictly a weak base whereas lactic acid is the corresponding acid. Lactic acidosis is often used clinically to describe elevated lactate but should be reserved for cases where there is a corresponding acidosis (pH below 7.35). Evidence: TAS. Frequency: Occasional (HP:0040283). (ORPHA:438114)
- Diffuse cerebral atrophy (HP:0002506): Diffuse unlocalised atrophy affecting the cerebrum. Evidence: TAS. Frequency: Occasional (HP:0040283). (ORPHA:438114)
- Pseudobulbar paralysis (HP:0007024): Bilateral impairment of the function of the cranial nerves 9-12, which control musculature involved in eating, swallowing, and speech. Pseudobulbar paralysis is characterized clinically by dysarthria, dysphonia, and dysphagia with bifacial paralysis, and may be accompanied by Pseudobulbar behavioral symptoms such as enforced crying and laughing. Evidence: TAS. Frequency: Occasional (HP:0040283). (ORPHA:438114)
- Absent smooth pursuit (HP:0007179): A complete lack of the ability to track objects with the ocular smooth pursuit system, a class of rather slow eye movements that minimizes retinal target motion. Evidence: TAS. Frequency: Occasional (HP:0040283). (ORPHA:438114)
- Focal-onset seizure (HP:0007359): A focal-onset seizure is a type of seizure originating within networks limited to one hemisphere. They may be discretely localized or more widely distributed, and may originate in subcortical structures. Evidence: TAS. Frequency: Occasional (HP:0040283). (ORPHA:438114)